Phenotypes associated with the disease retinitis pigmentosa 48 (OMIM:613827):
- Macular degeneration (HP:0000608): A nonspecific term denoting degeneration of the retinal pigment epithelium and/or retinal photoreceptor cells of the macula lutea. Evidence: PCS. (PMID:15452722)
- Visual impairment (HP:0000505): Visual impairment (or vision impairment) is vision loss (of a person) to such a degree as to qualify as an additional support need through a significant limitation of visual capability resulting from either disease, trauma, or congenital or degenerative conditions that cannot be corrected by conventional means, such as refractive correction, medication, or surgery. Evidence: PCS. (PMID:15452722)
- Rod-cone dystrophy (HP:0000510): An inherited retinal disease subtype in which the rod photoreceptors appear to be more severely affected than the cone photoreceptors. Typical presentation is with nyctalopia (due to rod dysfunction) followed by loss of mid-peripheral field of vision, which gradually extends and leaves many patients with a small central island of vision due to the preservation of macular cones. Evidence: PCS. (PMID:15452722)
- Autosomal dominant inheritance (HP:0000006): A mode of inheritance that is observed for traits related to a gene encoded on one of the autosomes (i.e., the human chromosomes 1-22) in which a trait manifests in heterozygotes. In the context of medical genetics, an autosomal dominant disorder is caused when a single copy of the mutant allele is present. Males and females are affected equally, and can both transmit the disorder with a risk of 50% for each child of inheriting the mutant allele. Evidence: PCS. (PMID:15452722)